Phenotypes associated with the disease Bilateral frontal polymicrogyria (ORPHA:208444):
- Delayed speech and language development (HP:0000750): A degree of language development that is significantly below the norm for a child of a specified age. Evidence: TAS. Frequency: Very frequent (HP:0040281). (ORPHA:208444)
- Intellectual disability (HP:0001249): The term intellectual disability or intellectual developmental disorder is used to describe significantly sub-average intellectual and adaptive functioning based on clinical assessment and as measured by individually administered, appropriately normed, standardized and validated tests of intellectual functioning and adaptive behavior, with onset during the developmental period from infancy through adolescence. Evidence: TAS. Frequency: Very frequent (HP:0040281). (ORPHA:208444)
- Global developmental delay (HP:0001263): A delay in the achievement of motor or mental milestones in the domains of development of a child, including motor skills, speech and language, cognitive skills, and social and emotional skills. This term should only be used to describe children younger than five years of age. Evidence: TAS. Frequency: Very frequent (HP:0040281). (ORPHA:208444)
- Mild intellectual disability (HP:0001256): Mild intellectual disability (ID) is defined as a type of ID characterized by mildly sub-average adaptive functioning and intellectual functioning, with an intelligence quotient (IQ) the range of 50-69. Evidence: TAS. Frequency: Frequent (HP:0040282). (ORPHA:208444)
- Spastic tetraparesis (HP:0001285): Spastic weakness affecting all four limbs. Evidence: TAS. Frequency: Frequent (HP:0040282). (ORPHA:208444)
- Seizure (HP:0001250): A seizure is an intermittent abnormality of nervous system physiology characterized by a transient occurrence of signs and/or symptoms due to abnormal excessive or synchronous neuronal activity in the brain. Evidence: TAS. Frequency: Occasional (HP:0040283). (ORPHA:208444)
- Hemiparesis (HP:0001269): Loss of strength in the arm, leg, and sometimes face on one side of the body. Hemiplegia refers to a complete loss of strength, whereas hemiparesis refers to an incomplete loss of strength. Evidence: TAS. Frequency: Occasional (HP:0040283). (ORPHA:208444)
- EEG abnormality (HP:0002353): Abnormality observed by electroencephalogram (EEG), which is used to record of the brain's spontaneous electrical activity from multiple electrodes placed on the scalp. Evidence: TAS. Frequency: Occasional (HP:0040283). (ORPHA:208444)
- Functional motor deficit (HP:0004302). Evidence: TAS. Frequency: Occasional (HP:0040283). (ORPHA:208444)
- Hyperactive deep tendon reflexes (HP:0006801). Evidence: TAS. Frequency: Occasional (HP:0040283). (ORPHA:208444)
Not associated with this disease:
- Pseudobulbar signs (HP:0002200): Pseudobulbar signs result from injury to an upper motor neuron lesion to the corticobulbar pathways in the pyramidal tract. Patients have difficulty chewing, swallowing and demonstrate slurred speech (often initial presentation) as well as abnormal behavioral symptoms such as inappropriate emotional outbursts of uncontrolled laughter or weeping etc. Evidence: TAS. (ORPHA:208444)